Phenotypes associated with the disease Adult polyglucosan body disease (ORPHA:206583):
- Neurogenic bladder (HP:0000011): A type of bladder dysfunction caused by neurologic damage. Neurogenic bladder can be flaccid or spastic. Common manifestatios of neurogenic bladder are overflow incontinence, frequency, urgency, urge incontinence, and retention. Evidence: TAS. Frequency: Very frequent (HP:0040281). (ORPHA:206583)
- Urinary incontinence (HP:0000020): Loss of the ability to control the urinary bladder leading to involuntary urination. Evidence: TAS. Frequency: Very frequent (HP:0040281). (ORPHA:206583)
- Atypical behavior (HP:0000708): Atypical behavior is an abnormality in a person's actions that can be controlled or modulated by the will of the individual. While abnormal behaviors can be difficult to control, they are distinct from other abnormal actions that cannot be affected by the individual's will. Evidence: TAS. Frequency: Frequent (HP:0040282). (ORPHA:206583)
- Dementia (HP:0000726): A loss of global cognitive ability of sufficient amount to interfere with normal social or occupational function. Dementia represents a loss of previously present cognitive abilities, generally in adults, and can affect memory, thinking, language, judgment, and behavior. Evidence: TAS. Frequency: Occasional (HP:0040283). (ORPHA:206583)
- Intellectual disability (HP:0001249): The term intellectual disability or intellectual developmental disorder is used to describe significantly sub-average intellectual and adaptive functioning based on clinical assessment and as measured by individually administered, appropriately normed, standardized and validated tests of intellectual functioning and adaptive behavior, with onset during the developmental period from infancy through adolescence. Evidence: TAS. Frequency: Very frequent (HP:0040281). (ORPHA:206583)
- Ataxia (HP:0001251): Ataxia refers to impaired coordination of voluntary muscle movement. Cerebellar ataxia refers to ataxia due to dysfunction of the cerebellum. This causes a variety of elementary neurological deficits including asynergy (lack of coordination between muscles, limbs and joints), dysmetria (lack of ability to judge distances that can lead to under- or overshoot in grasping movements), and dysdiadochokinesia (inability to perform rapid movements requiring antagonizing muscle groups to be switched on and off repeatedly). Evidence: TAS. Frequency: Occasional (HP:0040283). (ORPHA:206583)
- Spasticity (HP:0001257): A motor disorder characterized by a velocity-dependent increase in tonic stretch reflexes with increased muscle tone, exaggerated (hyperexcitable) tendon reflexes. Evidence: TAS. Frequency: Very frequent (HP:0040281). (ORPHA:206583)
- Hemiparesis (HP:0001269): Loss of strength in the arm, leg, and sometimes face on one side of the body. Hemiplegia refers to a complete loss of strength, whereas hemiparesis refers to an incomplete loss of strength. Evidence: TAS. Frequency: Very frequent (HP:0040281). (ORPHA:206583)
- Gait disturbance (HP:0001288): The term gait disturbance can refer to any disruption of the ability to walk. Evidence: TAS. Frequency: Very frequent (HP:0040281). (ORPHA:206583)
- Muscle weakness (HP:0001324): Reduced strength of muscles. Evidence: TAS. Frequency: Very frequent (HP:0040281). (ORPHA:206583)
- Limitation of joint mobility (HP:0001376): A reduction in the freedom of movement of one or more joints. Evidence: TAS. Frequency: Occasional (HP:0040283). (ORPHA:206583)
- Abnormality of extrapyramidal motor function (HP:0002071): A neurological condition related to lesions of the basal ganglia leading to typical abnormalities including akinesia (inability to initiate changes in activity and perform volitional movements rapidly and easily), muscular rigidity (continuous contraction of muscles with constant resistance to passive movement), chorea (widespread arrhythmic movements of a forcible, rapid, jerky, and restless nature), athetosis (inability to sustain the muscles of the fingers, toes, or other group of muscles in a fixed position), and akathisia (inability to remain motionless). Evidence: TAS. Frequency: Occasional (HP:0040283). (ORPHA:206583)
- Urinary bladder sphincter dysfunction (HP:0002839): Abnormal function of a sphincter of the urinary bladder. Evidence: TAS. Frequency: Very frequent (HP:0040281). (ORPHA:206583)
- Distal sensory impairment (HP:0002936): An abnormal reduction in sensation in the distal portions of the extremities. Evidence: TAS. Frequency: Frequent (HP:0040282). (ORPHA:206583)
- EMG abnormality (HP:0003457): Abnormal results of investigations using electromyography (EMG). Evidence: TAS. Frequency: Occasional (HP:0040283). (ORPHA:206583)
- Abnormal pyramidal sign (HP:0007256): Functional neurological abnormalities related to dysfunction of the pyramidal tract. Evidence: TAS. Frequency: Very frequent (HP:0040281). (ORPHA:206583)
- Peripheral neuropathy (HP:0009830): Peripheral neuropathy is a general term for any disorder of the peripheral nervous system. The main clinical features used to classify peripheral neuropathy are distribution, type (mainly demyelinating versus mainly axonal), duration, and course. Evidence: TAS. Frequency: Very frequent (HP:0040281). (ORPHA:206583)
- Skin ulcer (HP:0200042): A discontinuity of the skin exhibiting complete loss of the epidermis and often portions of the dermis and even subcutaneous fat. Evidence: TAS. Frequency: Frequent (HP:0040282). (ORPHA:206583)